- Blindness (HP:0000618): Blindness is the condition of lacking visual perception defined as a profound reduction in visual perception. On the 6m visual acuity scale, blindness is defined as less than 3/60. On the 20ft visual acuity scale, blindness is defined as less than 20/400. On the decimal visual acuity scale, blindness is defined as less than 0.05. Blindness is typically characterized by a visual field of no greater than 10 degrees in radius around central fixation. Evidence: IEA. (OMIM:254150)
- Autosomal recessive inheritance (HP:0000007): A mode of inheritance that is observed for traits related to a gene encoded on one of the autosomes (i.e., the human chromosomes 1-22) in which a trait manifests in individuals with two pathogenic alleles, either homozygotes (two copies of the same mutant allele) or compound heterozygotes (whereby each copy of a gene has a distinct mutant allele). Evidence: IEA. (OMIM:254150)
- Anosmia (HP:0000458): An inability to perceive odors. This is a general term describing inability to smell arising in any part of the process of smelling from absorption of odorants into the nasal mucous overlying the olfactory epithelium, diffusion to the cilia, binding to olfactory receptor sites, generation of action potentials in olfactory neurons, and perception of a smell. Evidence: IEA. (OMIM:254150)
These phenotypes are associated with the disease musk, inability to smell (OMIM:254150).